- Abnormality of the immune system (HP:0002715): An abnormality of the immune system. Evidence: IEA. (OMIM:312210)
- X-linked inheritance (HP:0001417): A mode of inheritance that is observed for traits related to a gene encoded on the X chromosome. Evidence: IEA. (OMIM:312210)
These phenotypes are associated with the disease radiation sensitivity of natural killer activity (OMIM:312210).